- Enlarged joints (HP:0003037): Increase in size of one or more joints. Evidence: TAS. Frequency: Very frequent (HP:0040281). (ORPHA:50809)
- Osteolysis of scaphoids (HP:0006202). Evidence: TAS. Frequency: Very frequent (HP:0040281). (ORPHA:50809)
- Osteolysis of patellae (HP:0006378). Evidence: TAS. Frequency: Very frequent (HP:0040281). (ORPHA:50809)
- Osteolysis of talus (HP:0008095): Osteolysis affecting the talus. Evidence: TAS. Frequency: Very frequent (HP:0040281). (ORPHA:50809)
- Short 4th metacarpal (HP:0010044): Short fourth metacarpal bone. Evidence: TAS. Frequency: Very frequent (HP:0040281). (ORPHA:50809)
- Synovitis (HP:0100769). Evidence: TAS. Frequency: Very frequent (HP:0040281). (ORPHA:50809)
These phenotypes are associated with the disease Talo-patello-scaphoid osteolysis (ORPHA:50809).